- Metaphyseal chondromatosis of humerus (HP:0030298). Evidence: PCS. (PMID:17632779)
- Metaphyseal chondromatosis of femur (HP:0030295). Evidence: PCS. (PMID:17632779)
- Autosomal dominant inheritance (HP:0000006): A mode of inheritance that is observed for traits related to a gene encoded on one of the autosomes (i.e., the human chromosomes 1-22) in which a trait manifests in heterozygotes. In the context of medical genetics, an autosomal dominant disorder is caused when a single copy of the mutant allele is present. Males and females are affected equally, and can both transmit the disorder with a risk of 50% for each child of inheriting the mutant allele. Evidence: PCS. (PMID:17632779)
These phenotypes are associated with the disease genochondromatosis (OMIM:137360).